- T-wave inversion in the right precordial leads (HP:0003140). Evidence: TAS. (OMIM:602086)
- Ventricular arrhythmia (HP:0004308). Evidence: TAS. (OMIM:602086)
- Right ventricular cardiomyopathy (HP:0011663): Right ventricular dysfunction (global or regional) with functional and morphological right ventricular abnormalities, with or without left ventricular disease. Evidence: TAS. (OMIM:602086)
- Focal necrosis of right ventricular muscle cells (HP:0003338). Evidence: TAS. (OMIM:602086)
- Autosomal dominant inheritance (HP:0000006): A mode of inheritance that is observed for traits related to a gene encoded on one of the autosomes (i.e., the human chromosomes 1-22) in which a trait manifests in heterozygotes. In the context of medical genetics, an autosomal dominant disorder is caused when a single copy of the mutant allele is present. Males and females are affected equally, and can both transmit the disorder with a risk of 50% for each child of inheriting the mutant allele. Evidence: TAS. (OMIM:602086)
These phenotypes are associated with the disease arrhythmogenic right ventricular dysplasia 3 (OMIM:602086).